Phenotypes associated with the disease Catel-Manzke syndrome (ORPHA:1388):
- Camptodactyly of finger (HP:0100490): The distal interphalangeal joint and/or the proximal interphalangeal joint of the fingers cannot be extended to 180 degrees by either active or passive extension. Evidence: TAS. Frequency: Occasional (HP:0040283). (ORPHA:1388)
- Glossoptosis (HP:0000162): Posterior displacement of the tongue into the pharynx, i.e., a tongue that is mislocalised posteriorly. Evidence: TAS. Frequency: Very frequent (HP:0040281). (ORPHA:1388)
- Cleft palate (HP:0000175): Cleft palate is a developmental defect of the palate resulting from a failure of fusion of the palatine processes and manifesting as a separation of the roof of the mouth (soft and hard palate). Evidence: TAS. Frequency: Very frequent (HP:0040281). (ORPHA:1388)
- Malar flattening (HP:0000272): Underdevelopment of the malar prominence of the jugal bone (zygomatic bone in mammals), appreciated in profile, frontal view, and/or by palpation. Evidence: TAS. Frequency: Very frequent (HP:0040281). (ORPHA:1388)
- Micrognathia (HP:0000347): Developmental hypoplasia of the mandible. Evidence: TAS. Frequency: Very frequent (HP:0040281). (ORPHA:1388)
- Failure to thrive (HP:0001508): Failure to thrive (FTT) refers to a child whose physical growth is substantially below the norm. Evidence: TAS. Frequency: Very frequent (HP:0040281). (ORPHA:1388)
- Clinodactyly of the 5th finger (HP:0004209): Clinodactyly refers to a bending or curvature of the fifth finger in the radial direction (i.e., towards the 4th finger). Evidence: TAS. Frequency: Very frequent (HP:0040281). (ORPHA:1388)
- Abnormal epiphysis morphology (HP:0005930): An anomaly of epiphysis, which is the expanded articular end of a long bone that developes from a secondary ossification center, and which during the period of growth is either entirely cartilaginous or is separated from the shaft by a cartilaginous disk. Evidence: TAS. Frequency: Very frequent (HP:0040281). (ORPHA:1388)
- Full cheeks (HP:0000293): Increased prominence or roundness of soft tissues between zygomata and mandible. Evidence: TAS. Frequency: Frequent (HP:0040282). (ORPHA:1388)
- Chronic otitis media (HP:0000389): Chronic otitis media refers to fluid, swelling, or infection of the middle ear that does not heal and may cause permanent damage to the ear. Evidence: TAS. Frequency: Frequent (HP:0040282). (ORPHA:1388)
- Joint stiffness (HP:0001387): Joint stiffness is a perceived sensation of tightness in a joint or joints when attempting to move them after a period of inactivity. Joint stiffness typically subsides over time. Evidence: TAS. Frequency: Frequent (HP:0040282). (ORPHA:1388)
- Ventricular septal defect (HP:0001629): A hole between the two bottom chambers (ventricles) of the heart. The defect is centered around the most superior aspect of the ventricular septum. Evidence: TAS. Frequency: Frequent (HP:0040282). (ORPHA:1388)
- Highly arched eyebrow (HP:0002553): Increased height of the central portion of the eyebrow, forming a crescent, semicircular, or inverted U shape. Evidence: TAS. Frequency: Frequent (HP:0040282). (ORPHA:1388)
- Scoliosis (HP:0002650): The presence of an abnormal lateral curvature of the spine. Evidence: TAS. Frequency: Frequent (HP:0040282). (ORPHA:1388)
- Short stature (HP:0004322): A height below that which is expected according to age and gender norms. Although there is no universally accepted definition of short stature, many refer to "short stature" as height more than 2 standard deviations below the mean for age and gender (or below the 3rd percentile for age and gender dependent norms). Evidence: TAS. Frequency: Frequent (HP:0040282). (ORPHA:1388)
- Abnormal cardiovascular system morphology (HP:0030680): Any structural anomaly of the heart and blood vessels. Evidence: TAS. Frequency: Frequent (HP:0040282). (ORPHA:1388)
- Hypertelorism (HP:0000316): Interpupillary distance more than 2 SD above the mean (alternatively, the appearance of an increased interpupillary distance or widely spaced eyes). Evidence: TAS. Frequency: Occasional (HP:0040283). (ORPHA:1388)
- Pectus excavatum (HP:0000767): A defect of the chest wall characterized by a depression of the sternum, giving the chest ("pectus") a caved-in ("excavatum") appearance. Evidence: TAS. Frequency: Occasional (HP:0040283). (ORPHA:1388)
- Atrial septal defect (HP:0001631): Atrial septal defect (ASD) is a congenital abnormality of the interatrial septum that enables blood flow between the left and right atria via the interatrial septum. Evidence: TAS. Frequency: Occasional (HP:0040283). (ORPHA:1388)
- Ventriculomegaly (HP:0002119): An increase in size of the ventricular system of the brain. Evidence: TAS. Frequency: Occasional (HP:0040283). (ORPHA:1388)
- Radial deviation of the 2nd finger (HP:0009467): Displacement of the 2nd finger towards the radial side. Evidence: TAS. Frequency: Occasional (HP:0040283). (ORPHA:1388)
- Oral synechia (HP:0010285): Fibrous band between the mucosal surfaces of the upper and lower alveolar ridges. Evidence: TAS. Frequency: Occasional (HP:0040283). (ORPHA:1388)
- Metatarsus valgus (HP:0010508): A condition in which the anterior part of the foot rotates outward away from the midline of the body and the heel remains straight. Evidence: TAS. Frequency: Occasional (HP:0040283). (ORPHA:1388)
- Posteriorly rotated ears (HP:0000358): A type of abnormal location of the ears in which the position of the ears is characterized by posterior rotation (the superior part of the ears is rotated towards the back of the head, and the inferior part of the ears towards the front). Evidence: TAS. Frequency: Frequent (HP:0040282). (ORPHA:1388)
- Joint hypermobility (HP:0001382): The capability that a joint (or a group of joints) has to move, passively and/or actively, beyond normal limits along physiological axes. Evidence: TAS. Frequency: Occasional (HP:0040283). (ORPHA:1388)